Phenotypes associated with the disease exostoses, multiple, type III (OMIM:600209):
- Multiple exostoses (HP:0002762): Presence of more than one exostosis. An exostosis is a benign growth the projects outward from the bone surface. It is capped by cartilage, and arises from a bone that develops from cartilage. Evidence: IEA. (OMIM:600209)
- Autosomal dominant inheritance (HP:0000006): A mode of inheritance that is observed for traits related to a gene encoded on one of the autosomes (i.e., the human chromosomes 1-22) in which a trait manifests in heterozygotes. In the context of medical genetics, an autosomal dominant disorder is caused when a single copy of the mutant allele is present. Males and females are affected equally, and can both transmit the disorder with a risk of 50% for each child of inheriting the mutant allele. Evidence: IEA. (OMIM:600209)